- Chronic pulmonary obstruction (HP:0006510): An anomaly that is characterized progressive airflow obstruction that is only partly reversible, inflammation in the airways, and systemic effects or comorbities. Evidence: TAS. (OMIM:606963)
This phenotype is associated with the disease chronic obstructive pulmonary disease (OMIM:606963).